Phenotypes associated with the disease mitochondrial complex I deficiency, nuclear type 4 (OMIM:618225):
- Lethargy (HP:0001254): A state of fatigue, either physical or mental slowness and sluggishness, with difficulties in initiating or performing simple tasks. Distinguished from apathy which implies indifference and a lack of desire or interest in the task. A person with lethargy may have the desire, but not the energy to engage in personal or socially relevant tasks. Evidence: IEA. (OMIM:618225)
- Strabismus (HP:0000486): A misalignment of the eyes so that the visual axes deviate from bifoveal fixation. The classification of strabismus may be based on a number of features including the relative position of the eyes, whether the deviation is latent or manifest, intermittent or constant, concomitant or otherwise and according to the age of onset and the relevance of any associated refractive error. Evidence: PCS. Frequency: 2/3. (PMID:10080174)
- Seizure (HP:0001250): A seizure is an intermittent abnormality of nervous system physiology characterized by a transient occurrence of signs and/or symptoms due to abnormal excessive or synchronous neuronal activity in the brain. Evidence: IEA. (OMIM:618225)
- Hypotonia (HP:0001252): Hypotonia is an abnormally low muscle tone (the amount of tension or resistance to movement in a muscle). Even when relaxed, muscles have a continuous and passive partial contraction which provides some resistance to passive stretching. Hypotonia thus manifests as diminished resistance to passive stretching. Hypotonia is not the same as muscle weakness, although the two conditions can co-exist. Evidence: PCS. Frequency: 3/3. (PMID:10080174)
- Infantile onset (HP:0003593): Onset of signs or symptoms of disease between 28 days to one year of life. Evidence: PCS. Frequency: 3/3. (PMID:10080174)
- Ataxia (HP:0001251): Ataxia refers to impaired coordination of voluntary muscle movement. Cerebellar ataxia refers to ataxia due to dysfunction of the cerebellum. This causes a variety of elementary neurological deficits including asynergy (lack of coordination between muscles, limbs and joints), dysmetria (lack of ability to judge distances that can lead to under- or overshoot in grasping movements), and dysdiadochokinesia (inability to perform rapid movements requiring antagonizing muscle groups to be switched on and off repeatedly). Evidence: IEA. (OMIM:618225)
- Myoclonic seizure (HP:0032794): A myoclonic seizure is a type of motor seizure characterized by sudden, brief (<100 ms) involuntary single or multiple contraction of muscles or muscle groups of variable topography (axial, proximal limb, distal). Myoclonus is less regularly repetitive and less sustained than is clonus. Evidence: PCS. Frequency: 3/3. (PMID:10080174)
- Brain atrophy (HP:0012444): Partial or complete wasting (loss) of brain tissue that was once present. Evidence: PCS. Frequency: 3/3. (PMID:10080174)
- Blindness (HP:0000618): Blindness is the condition of lacking visual perception defined as a profound reduction in visual perception. On the 6m visual acuity scale, blindness is defined as less than 3/60. On the 20ft visual acuity scale, blindness is defined as less than 20/400. On the decimal visual acuity scale, blindness is defined as less than 0.05. Blindness is typically characterized by a visual field of no greater than 10 degrees in radius around central fixation. Evidence: PCS. Frequency: 1/1. (PMID:10080174)
- Macrocephaly (HP:0000256): Occipitofrontal (head) circumference greater than 97th centile compared to appropriate, age matched, sex-matched normal standards. Alternatively, a apparently increased size of the cranium. Evidence: PCS. Frequency: 1/2. (PMID:10080174)
- Leukodystrophy (HP:0002415): Leukodystrophy refers to deterioration of white matter of the brain resulting from degeneration of myelin sheaths in the CNS. Their basic defect is directly related to the synthesis and maintenance of myelin membranes. Symmetric white matter involvement at MRI is a typical finding in patients with leukodystrophies. Evidence: PCS. Frequency: 1/2. (PMID:10080174)
- Metabolic acidosis (HP:0001942): Metabolic acidosis (MA) is characterized by a fall in blood pH due to a reduction of serum bicarbonate concentration. This can occur as a result of either the accumulation of acids (high anion gap MA) or the loss of bicarbonate from the gastrointestinal tract or the kidney (hyperchloremic MA). By definition, MA is not due to a respirary cause. Evidence: IEA. (OMIM:618225)
- Vomiting (HP:0002013): Forceful ejection of the contents of the stomach through the mouth by means of a series of involuntary spasmic contractions. Evidence: PCS. Frequency: 2/3. (PMID:10080174)
- Developmental regression (HP:0002376): Loss of developmental skills, as manifested by loss of developmental milestones. Evidence: PCS. Frequency: 2/3. (PMID:10080174)
- Increased circulating pyruvate concentration (HP:0003542): The concentration of pyruvate in the blood circulation is above the upper limit of normal. Evidence: PCS. Frequency: 2/2. (PMID:10080174)
- Global developmental delay (HP:0001263): A delay in the achievement of motor or mental milestones in the domains of development of a child, including motor skills, speech and language, cognitive skills, and social and emotional skills. This term should only be used to describe children younger than five years of age. Evidence: PCS. (PMID:10080174)
- Increased circulating lactate concentration (HP:0002151): Abnormally increased level of blood lactate (2-hydroxypropanoic acid). Lactate is produced from pyruvate by lactate dehydrogenase during normal metabolism. The terms lactate and lactic acid are often used interchangeably but lactate (the component measured in blood) is strictly a weak base whereas lactic acid is the corresponding acid. Lactic acidosis is often used clinically to describe elevated lactate but should be reserved for cases where there is a corresponding acidosis (pH below 7.35). Evidence: PCS. Frequency: 2/3. (PMID:10080174)
- Increased CSF lactate (HP:0002490): Increased concentration of lactate in the cerebrospinal fluid. Evidence: PCS. Frequency: 3/3. (PMID:10080174)
- Decreased activity of mitochondrial complex I (HP:0011923): A reduction in the activity of the mitochondrial respiratory chain complex I, which is part of the electron transport chain in mitochondria. Evidence: PCS. Frequency: 3/3. (PMID:10080174)
- Death in childhood (HP:0003819): Death in during childhood, defined here as between the ages of 2 and 10 years. Evidence: PCS. Frequency: 1/3. (PMID:10080174)
- Ptosis (HP:0000508): The upper eyelid margin is positioned 3 mm or more lower than usual and covers the superior portion of the iris (objective); or, the upper lid margin obscures at least part of the pupil (subjective). Evidence: IEA. (OMIM:618225)
- Ophthalmoplegia (HP:0000602): Paralysis of one or more extraocular muscles that are responsible for eye movements. Evidence: IEA. (OMIM:618225)
- Autosomal recessive inheritance (HP:0000007): A mode of inheritance that is observed for traits related to a gene encoded on one of the autosomes (i.e., the human chromosomes 1-22) in which a trait manifests in individuals with two pathogenic alleles, either homozygotes (two copies of the same mutant allele) or compound heterozygotes (whereby each copy of a gene has a distinct mutant allele). Evidence: PCS. (PMID:10080174)
- Spasticity (HP:0001257): A motor disorder characterized by a velocity-dependent increase in tonic stretch reflexes with increased muscle tone, exaggerated (hyperexcitable) tendon reflexes. Evidence: PCS. Frequency: 1/2. (PMID:10080174)
- Apnea (HP:0002104): Lack of breathing with no movement of the respiratory muscles and no exchange of air in the lungs. This term refers to a disposition to have recurrent episodes of apnea rather than to a single event. Evidence: IEA. (OMIM:618225)
- Myoclonus (HP:0001336): Very brief, involuntary random muscular contractions occurring at rest, in response to sensory stimuli, or accompanying voluntary movements. Evidence: PCS. (PMID:10080174)